Phenotypes associated with the disease HYPERCHOLESTEROLEMIA SUPPRESSOR (OMIM:144020):
- Autosomal dominant inheritance (HP:0000006): A mode of inheritance that is observed for traits related to a gene encoded on one of the autosomes (i.e., the human chromosomes 1-22) in which a trait manifests in heterozygotes. In the context of medical genetics, an autosomal dominant disorder is caused when a single copy of the mutant allele is present. Males and females are affected equally, and can both transmit the disorder with a risk of 50% for each child of inheriting the mutant allele. Evidence: IEA. (OMIM:144020)